Phenotypes associated with the disease Behcet disease (OMIM:109650):
- Hypopyon (HP:0031615): Presence of pus (appears as a white fluid) producing a fluid level in the inferior part of the anterior chamber. Evidence: IEA. (OMIM:109650)
- Patchy alopecia (HP:0002232): Transient, non-scarring hair loss and preservation of the hair follicle located in in well-defined patches. Evidence: IEA. (OMIM:109650)
- Oral ulcer (HP:0000155): Erosion of the mucous mebrane of the mouth with local excavation of the surface, resulting from the sloughing of inflammatory necrotic tissue. Evidence: TAS. (OMIM:109650)
- Iritis (HP:0001101): Inflammation of the iris. Evidence: IEA. (OMIM:109650)
- Epididymitis (HP:0000031): The presence of inflammation of the epididymis. Evidence: TAS. (OMIM:109650)
- Raynaud phenomenon (HP:0030880). Evidence: TAS. (OMIM:109650)
- Iridocyclitis (HP:0001094): A type of anterior uveitis, in which there is Inflammation of the iris and the ciliary body. Evidence: IEA. (OMIM:109650)
- Decreased level of D-mannose in urine (HP:0410060): A decrease in the level of D-mannose in the urine. Evidence: PCS. (PMID:29099052)
- Erythema nodosum (HP:0012219): An erythematous eruption commonly associated with drug reactions or infection and characterized by inflammatory nodules that are usually tender, multiple, and bilateral. Evidence: IEA. (OMIM:109650)
- Erythema (HP:0010783): Redness of the skin, caused by hyperemia of the capillaries in the lower layers of the skin. Evidence: IEA. (OMIM:109650)
- Chorioretinitis (HP:0012424): An inflammation of the choroid and retina. Evidence: TAS. (OMIM:109650)
- Irritability (HP:0000737): An emotional state characterized by negative feelings of heightened frustration, annoyance, or feeling upset, often triggered by internal factors (e.g., fatigue, hunger, unfulfilled desires) or external factors (e.g., social or environmental challenges). Irritability may be unpredictable, and is accompanied by a lowered threshold for emotional reactivity and observable features (speech, facial expressions, or psychomotor activity). Evidence: IEA. (OMIM:109650)
- Superficial thrombophlebitis (HP:0002638): Inflammation of a superficial vein associated with venous thrombosis (blood clot formation within the vein). Evidence: IEA. (OMIM:109650)
- Autosomal recessive inheritance (HP:0000007): A mode of inheritance that is observed for traits related to a gene encoded on one of the autosomes (i.e., the human chromosomes 1-22) in which a trait manifests in individuals with two pathogenic alleles, either homozygotes (two copies of the same mutant allele) or compound heterozygotes (whereby each copy of a gene has a distinct mutant allele). Evidence: TAS. (PMID:12955762)
- Arthritis (HP:0001369): Inflammation of a joint. Evidence: IEA. (OMIM:109650)
- Genital ulcers (HP:0003249). Evidence: TAS. (OMIM:109650)